Phenotypes associated with the disease congenital factor V deficiency (OMIM:227400):
- Menorrhagia (HP:0000132): Prolonged and excessive menses at regular intervals in excess of 80 mL or lasting longer than 7 days. Evidence: TAS. (OMIM:227400)
- Abnormal bleeding (HP:0001892): An abnormal susceptibility to bleeding, often referred to as a bleeding diathesis. A bleeding diathesis may be related to vascular, platelet and coagulation defects. Evidence: IEA. (OMIM:227400)
- Reduced coagulation factor V activity (HP:0003225): Decreased activity of coagulation factor V. Evidence: IEA. (OMIM:227400)
- Prolonged prothrombin time (HP:0008151): Increased time to coagulation in the prothrombin time test, which is a measure of the extrinsic pathway of coagulation. The results of the prothrombin time test are often expressed in terms of the International normalized ratio (INR), which is calculated as a ratio of the patient's prothrombin time (PT) to a control PT standardized for the potency of the thromboplastin reagent developed by the World Health Organization (WHO) using the formula: INR is equal to Patient PT divided by Control PT. Evidence: TAS. (OMIM:227400)
- Prolonged whole-blood clotting time (HP:0005542): An abnormal prolongation (delay) in the time required by whole blood to produce a visible clot. Evidence: IEA. (OMIM:227400)
- Prolonged bleeding time (HP:0003010): Prolongation of the time taken for a standardized skin cut of fixed depth and length to stop bleeding. Evidence: IEA. (OMIM:227400)
- Autosomal recessive inheritance (HP:0000007): A mode of inheritance that is observed for traits related to a gene encoded on one of the autosomes (i.e., the human chromosomes 1-22) in which a trait manifests in individuals with two pathogenic alleles, either homozygotes (two copies of the same mutant allele) or compound heterozygotes (whereby each copy of a gene has a distinct mutant allele). Evidence: IEA. (OMIM:227400)
- Bruising susceptibility (HP:0000978): An ecchymosis (bruise) refers to the skin discoloration caused by the escape of blood into the tissues from ruptured blood vessels. This term refers to an abnormally increased susceptibility to bruising. The corresponding phenotypic abnormality is generally elicited on medical history as a report of frequent ecchymoses or bruising without adequate trauma. Evidence: TAS. (OMIM:227400)
- Epistaxis (HP:0000421): Epistaxis, or nosebleed, refers to a hemorrhage localized in the nose. Evidence: TAS. (OMIM:227400)
- Prolonged partial thromboplastin time (HP:0003645): Increased time to coagulation in the partial thromboplastin time (PTT) test, a measure of the intrinsic and common coagulation pathways. Phospholipid, and activator, and calcium are mixed into an anticoagulated plasma sample, and the time is measured until a thrombus forms. Evidence: TAS. (OMIM:227400)